- Action tremor (HP:0002345): A tremor present when the limbs are active, either when outstretched in a certain position or throughout a voluntary movement. Evidence: PCS. (PMID:22863194)
- Postural tremor (HP:0002174): A type of tremors that is triggered by holding a limb in a fixed position. Evidence: PCS. (PMID:22863194)
- Autosomal dominant inheritance (HP:0000006): A mode of inheritance that is observed for traits related to a gene encoded on one of the autosomes (i.e., the human chromosomes 1-22) in which a trait manifests in heterozygotes. In the context of medical genetics, an autosomal dominant disorder is caused when a single copy of the mutant allele is present. Males and females are affected equally, and can both transmit the disorder with a risk of 50% for each child of inheriting the mutant allele. Evidence: PCS. (PMID:22863194)
These phenotypes are associated with the disease tremor, hereditary essential, 4 (OMIM:614782).